- Strabismus (HP:0000486): A misalignment of the eyes so that the visual axes deviate from bifoveal fixation. The classification of strabismus may be based on a number of features including the relative position of the eyes, whether the deviation is latent or manifest, intermittent or constant, concomitant or otherwise and according to the age of onset and the relevance of any associated refractive error. Evidence: TAS. Frequency: Very frequent (HP:0040281). (ORPHA:35737)
- Cataract (HP:0000518): A cataract is an opacity or clouding that develops in the crystalline lens of the eye or in its capsule. Evidence: TAS. Frequency: Occasional (HP:0040283). (ORPHA:35737)
- Retinal detachment (HP:0000541): Separation of the inner layers of the retina (neural retina) from the pigment epithelium. Evidence: TAS. Frequency: Occasional (HP:0040283). (ORPHA:35737)
- Optic disc coloboma (HP:0000588): A cleft of the optic nerve that extends inferiorly. Evidence: TAS. Frequency: Occasional (HP:0040283). (ORPHA:35737)
- Nystagmus (HP:0000639): Rhythmic, involuntary oscillations of one or both eyes related to abnormality in fixation, conjugate gaze, or vestibular mechanisms. Evidence: TAS. Frequency: Occasional (HP:0040283). (ORPHA:35737)
- Amblyopia (HP:0000646): Reduced visual acuity that is uncorrectable by lenses in the absence of detectable anatomic defects in the eye or visual pathways. Evidence: TAS. Frequency: Very frequent (HP:0040281). (ORPHA:35737)
- Abnormal retinal pigmentation (HP:0007703): Any deviation from the normal pigmentation of the retina. Evidence: TAS. Frequency: Very frequent (HP:0040281). (ORPHA:35737)
These phenotypes are associated with the disease Morning glory disc anomaly (ORPHA:35737).